Phenotypes associated with the disease THEOPHYLLINE BIOTRANSFORMATION (OMIM:187650):
- Autosomal dominant inheritance (HP:0000006): A mode of inheritance that is observed for traits related to a gene encoded on one of the autosomes (i.e., the human chromosomes 1-22) in which a trait manifests in heterozygotes. In the context of medical genetics, an autosomal dominant disorder is caused when a single copy of the mutant allele is present. Males and females are affected equally, and can both transmit the disorder with a risk of 50% for each child of inheriting the mutant allele. Evidence: IEA. (OMIM:187650)